- Progressive (HP:0003676): Applies to a disease manifestation that increases in scope or severity over the course of time, i.e., that worsens with age. Evidence: PCS. (PMID:20602916)
- Hearing impairment (HP:0000365): A decreased magnitude of the sensory perception of sound. Evidence: PCS. (PMID:20602916)
- Late young adult onset (HP:0025710): Onset of disease at an age of greater than or equal to 25 to under 40 years. Evidence: PCS. (PMID:20602916)
- Autosomal dominant inheritance (HP:0000006): A mode of inheritance that is observed for traits related to a gene encoded on one of the autosomes (i.e., the human chromosomes 1-22) in which a trait manifests in heterozygotes. In the context of medical genetics, an autosomal dominant disorder is caused when a single copy of the mutant allele is present. Males and females are affected equally, and can both transmit the disorder with a risk of 50% for each child of inheriting the mutant allele. Evidence: PCS. (PMID:20602916)
These phenotypes are associated with the disease autosomal dominant nonsyndromic hearing loss 51 (OMIM:613558).